- Epicanthus (HP:0000286): A fold of skin starting above the medial aspect of the upper eyelid and arching downward to cover, pass in front of and lateral to the medial canthus. Evidence: TAS. (OMIM:615465)
- Alobar holoprosencephaly (HP:0006988): A type of holoprosencephaly characterized by the presence of a single ventricle and no separation of the cerebral hemisphere. The single midline ventricle is often greatly enlarged. Evidence: PCS. Frequency: 2/7. (PMID:23812909)
- Bilateral tonic-clonic seizure (HP:0002069): A bilateral tonic-clonic seizure is a seizure defined by a tonic (bilateral increased tone, lasting seconds to minutes) and then a clonic (bilateral sustained rhythmic jerking) phase. Evidence: PCS. Frequency: 1/7. (PMID:23812909)
- Median cleft upper lip (HP:0000161): A type of cleft lip presenting as a midline (median) gap in the upper lip. Evidence: PCS. Frequency: 1/7. (PMID:23812909)
- Agenesis of corpus callosum (HP:0001274): Absence of the corpus callosum as a result of the failure of the corpus callosum to develop, which can be the result of a failure in any one of the multiple steps of callosal development including cellular proliferation and migration, axonal growth or glial patterning at the midline. Evidence: PCS. Frequency: 5/5. (PMID:23812909)
- Gonadotropin deficiency (HP:0008213): A reduced ability to secrete gonadotropins, which are protein hormones secreted by gonadotrope cells of the anterior pituitary gland, including the hormones follitropin (FSH) and luteinizing hormone (LH). Evidence: TAS. (OMIM:615465)
- Hypertelorism (HP:0000316): Interpupillary distance more than 2 SD above the mean (alternatively, the appearance of an increased interpupillary distance or widely spaced eyes). Evidence: PCS. Frequency: 2/7. (PMID:23812909)
- Lobar holoprosencephaly (HP:0006870): A type of holoprosencephaly in which most of the right and left cerebral hemispheres and lateral ventricles are separated but the most rostral aspect of the telencephalon, the frontal lobes, are fused, especially ventrally. Evidence: PCS. Frequency: 13/17. (PMID:23812909;OMIM:615465)
- Diabetes insipidus (HP:0000873): A state of excessive water intake and hypotonic (dilute) polyuria. Diabetes insipidus may be due to failure of vasopressin (AVP) release (central or neurogenic diabetes insipidus) or to a failure of the kidney to respond to AVP (nephrogenic diabetes insipidus). Evidence: TAS. (OMIM:615465)
- Hypernatremia (HP:0003228): The concentration of sodium in the blood circulation is above the upper limit of normal. Evidence: TAS. (OMIM:615465)
- Posteriorly rotated ears (HP:0000358): A type of abnormal location of the ears in which the position of the ears is characterized by posterior rotation (the superior part of the ears is rotated towards the back of the head, and the inferior part of the ears towards the front). Evidence: TAS. (OMIM:615465)
- Cleft palate (HP:0000175): Cleft palate is a developmental defect of the palate resulting from a failure of fusion of the palatine processes and manifesting as a separation of the roof of the mouth (soft and hard palate). Evidence: PCS. Frequency: 4/7. (PMID:23812909)
- Craniosynostosis (HP:0001363): Craniosynostosis refers to the premature closure of the cranial sutures. Primary craniosynostosis refers to the closure of one or more sutures due to abnormalities in skull development, and secondary craniosynostosis results from failure of brain growth. Evidence: TAS. Frequency: Occasional (HP:0040283). (OMIM:615465)
- Microcephaly (HP:0000252): Head circumference below 2 standard deviations below the mean for age and gender. Evidence: TAS. (OMIM:615465)
- Micropenis (HP:0000054): Abnormally small penis. At birth, the normal penis is about 3 cm (stretched length from pubic tubercle to tip of penis) with micropenis less than 2.0-2.5 cm. Evidence: PCS. Frequency: 3/5. (PMID:23812909)
- Hypoplasia of the frontal bone (HP:0005466): Underdevelopment of the frontal bone. Evidence: TAS. (OMIM:615465)
- Global developmental delay (HP:0001263): A delay in the achievement of motor or mental milestones in the domains of development of a child, including motor skills, speech and language, cognitive skills, and social and emotional skills. This term should only be used to describe children younger than five years of age. Evidence: PCS. Frequency: 16/16. (PMID:23812909;OMIM:615465)
- Ectrodactyly (HP:0100257): A condition in which middle parts of the hands and/or feet (digits and meta-carpals and -tarsals) are missing giving a cleft appearance. The severity is very variable ranging from slightly hypoplastic 3rd toe/fingers over absent 2nd or 3rd toes/fingers as far as oligo- or monodactyl hands and/or feet. Evidence: PCS. Frequency: 6/7. (PMID:23812909)
- Hypotelorism (HP:0000601): Interpupillary distance less than 2 SD below the mean (alternatively, the appearance of an decreased interpupillary distance or closely spaced eyes). Evidence: PCS. Frequency: 2/7. (PMID:23812909)
- Semilobar holoprosencephaly (HP:0002507): A type of holoprosencephaly in which the left and right frontal and parietal lobes are fused and the interhemispheric fissure is only present posteriorly. Evidence: PCS. Frequency: 2/7. (PMID:23812909)
- Neonatal hypotonia (HP:0001319): Muscular hypotonia (abnormally low muscle tone) manifesting in the neonatal period. Evidence: TAS. (OMIM:615465)
- Syndactyly (HP:0001159): Webbing or fusion of the fingers or toes, involving soft parts only or including bone structure. Bony fusions are referred to as "bony" syndactyly if the fusion occurs in a radio-ulnar axis. Fusions of bones of the fingers or toes in a proximo-distal axis are referred to as "symphalangism". Evidence: TAS. (OMIM:615465)
- Hypospadias (HP:0000047): Abnormal position of urethral meatus on the ventral penile shaft (underside) characterized by displacement of the urethral meatus from the tip of the glans penis to the ventral surface of the penis, scrotum, or perineum. Evidence: TAS. (OMIM:615465)
- Growth delay (HP:0001510): A deficiency or slowing down of growth pre- and postnatally. Evidence: PCS. Frequency: 6/6. (PMID:23812909)
- Autosomal dominant inheritance (HP:0000006): A mode of inheritance that is observed for traits related to a gene encoded on one of the autosomes (i.e., the human chromosomes 1-22) in which a trait manifests in heterozygotes. In the context of medical genetics, an autosomal dominant disorder is caused when a single copy of the mutant allele is present. Males and females are affected equally, and can both transmit the disorder with a risk of 50% for each child of inheriting the mutant allele. Evidence: PCS. (PMID:23812909)
- Cleft upper lip (HP:0000204): A gap or groove in the upper lip. This is a congenital defect resulting from nonfusion of tissues of the lip during embryonal development. Evidence: PCS. Frequency: 3/7. (PMID:23812909)
- Cryptorchidism (HP:0000028): Testis in inguinal canal. That is, absence of one or both testes from the scrotum owing to failure of the testis or testes to descend through the inguinal canal to the scrotum. Evidence: PCS. Frequency: 3/5. (PMID:23812909)
- Low-set ears (HP:0000369): Upper insertion of the ear to the scalp below an imaginary horizontal line drawn between the inner canthi of the eye and extending posteriorly to the ear. Evidence: TAS. (OMIM:615465)
- Wide nose (HP:0000445): Interalar distance more than two standard deviations above the mean for age, i.e., an apparently increased width of the nasal base and alae. Evidence: TAS. (OMIM:615465)
These phenotypes are associated with the disease Hartsfield-Bixler-Demyer syndrome (OMIM:615465).